Phenotypes associated with the disease Cleft palate-large ears-small head syndrome (ORPHA:2013):
- Hypospadias (HP:0000047): Abnormal position of urethral meatus on the ventral penile shaft (underside) characterized by displacement of the urethral meatus from the tip of the glans penis to the ventral surface of the penis, scrotum, or perineum. Evidence: TAS. Frequency: Frequent (HP:0040282). (ORPHA:2013)
- Cleft palate (HP:0000175): Cleft palate is a developmental defect of the palate resulting from a failure of fusion of the palatine processes and manifesting as a separation of the roof of the mouth (soft and hard palate). Evidence: TAS. Frequency: Very frequent (HP:0040281). (ORPHA:2013)
- Gingival overgrowth (HP:0000212): Hyperplasia of the gingiva (that is, a thickening of the soft tissue overlying the alveolar ridge. The degree of thickening ranges from involvement of the interdental papillae alone to gingival overgrowth covering the entire tooth crown. Evidence: TAS. Frequency: Frequent (HP:0040282). (ORPHA:2013)
- Microcephaly (HP:0000252): Head circumference below 2 standard deviations below the mean for age and gender. Evidence: TAS. Frequency: Very frequent (HP:0040281). (ORPHA:2013)
- Micrognathia (HP:0000347): Developmental hypoplasia of the mandible. Evidence: TAS. Frequency: Frequent (HP:0040282). (ORPHA:2013)
- Macrotia (HP:0000400): Median longitudinal ear length greater than two standard deviations above the mean and median ear width greater than two standard deviations above the mean (objective); or, apparent increase in length and width of the pinna (subjective). Evidence: TAS. Frequency: Very frequent (HP:0040281). (ORPHA:2013)
- Protruding ear (HP:0000411): Angle formed by the plane of the ear and the mastoid bone greater than the 97th centile for age (objective); or, outer edge of the helix more than 2 cm from the mastoid at the point of maximum distance (objective). Evidence: TAS. Frequency: Frequent (HP:0040282). (ORPHA:2013)
- Ptosis (HP:0000508): The upper eyelid margin is positioned 3 mm or more lower than usual and covers the superior portion of the iris (objective); or, the upper lid margin obscures at least part of the pupil (subjective). Evidence: TAS. Frequency: Frequent (HP:0040282). (ORPHA:2013)
- Pectus excavatum (HP:0000767): A defect of the chest wall characterized by a depression of the sternum, giving the chest ("pectus") a caved-in ("excavatum") appearance. Evidence: TAS. Frequency: Frequent (HP:0040282). (ORPHA:2013)
- Hypotonia (HP:0001252): Hypotonia is an abnormally low muscle tone (the amount of tension or resistance to movement in a muscle). Even when relaxed, muscles have a continuous and passive partial contraction which provides some resistance to passive stretching. Hypotonia thus manifests as diminished resistance to passive stretching. Hypotonia is not the same as muscle weakness, although the two conditions can co-exist. Evidence: TAS. Frequency: Frequent (HP:0040282). (ORPHA:2013)
- Global developmental delay (HP:0001263): A delay in the achievement of motor or mental milestones in the domains of development of a child, including motor skills, speech and language, cognitive skills, and social and emotional skills. This term should only be used to describe children younger than five years of age. Evidence: TAS. Frequency: Frequent (HP:0040282). (ORPHA:2013)
- Hypoplastic toenails (HP:0001800): Underdevelopment of the toenail. Evidence: TAS. Frequency: Frequent (HP:0040282). (ORPHA:2013)
- Delayed skeletal maturation (HP:0002750): A decreased rate of skeletal maturation. Delayed skeletal maturation can be diagnosed on the basis of an estimation of the bone age from radiographs of specific bones in the human body. Evidence: TAS. Frequency: Very frequent (HP:0040281). (ORPHA:2013)
- Skeletal muscle atrophy (HP:0003202): The presence of skeletal muscular atrophy (which is also known as amyotrophy). Evidence: TAS. Frequency: Frequent (HP:0040282). (ORPHA:2013)
- Short stature (HP:0004322): A height below that which is expected according to age and gender norms. Although there is no universally accepted definition of short stature, many refer to "short stature" as height more than 2 standard deviations below the mean for age and gender (or below the 3rd percentile for age and gender dependent norms). Evidence: TAS. Frequency: Very frequent (HP:0040281). (ORPHA:2013)
- Elfin facies (HP:0004428): This is a description previously used to describe a facial form characterized by a short, upturned nose, wide mouth, widely spaced eyes, and full cheeks. Because of the imprecision in this definition it is preferable to describe these features precisely. This term is retained because it was often used in the past, but it should not be used for new annotations. Evidence: TAS. Frequency: Frequent (HP:0040282). (ORPHA:2013)
- Aplasia/Hypoplasia of the nipples (HP:0006709). Evidence: TAS. Frequency: Frequent (HP:0040282). (ORPHA:2013)
- Ulnar deviation of finger (HP:0009465): Bending or curvature of a finger toward the ulnar side (i.e., away from the thumb). The deviation is at the metacarpal-phalangeal joint, and this finding is distinct from clinodactyly. Evidence: TAS. Frequency: Frequent (HP:0040282). (ORPHA:2013)
- Short distal phalanx of finger (HP:0009882): Short distance from the end of the finger to the most distal interphalangeal crease or the distal interphalangeal joint flexion point. That is, hypoplasia of one or more of the distal phalanx of finger. Evidence: TAS. Frequency: Frequent (HP:0040282). (ORPHA:2013)